- Dolichocephaly (HP:0000268): An abnormality of skull shape characterized by a increased anterior-posterior diameter, i.e., an increased antero-posterior dimension of the skull. Cephalic index less than 76%. Alternatively, an apparently increased antero-posterior length of the head compared to width. Often due to premature closure of the sagittal suture. Evidence: TAS. Frequency: Very frequent (HP:0040281). (ORPHA:35093)
- Prominent occiput (HP:0000269): Increased convexity of the occiput (posterior part of the skull). Evidence: TAS. Frequency: Occasional (HP:0040283). (ORPHA:35093)
- Frontal bossing (HP:0002007): Bilateral bulging of the lateral frontal bone prominences with relative sparing of the midline. Evidence: TAS. Frequency: Occasional (HP:0040283). (ORPHA:35093)
- Increased intracranial pressure (HP:0002516): An increase of the pressure inside the cranium (skull) and thereby in the brain tissue and cerebrospinal fluid. Evidence: TAS. Frequency: Occasional (HP:0040283). (ORPHA:35093)
These phenotypes are associated with the disease Non-syndromic sagittal craniosynostosis (ORPHA:35093).